- Pointed chin (HP:0000307): A marked tapering of the lower face to the chin. Evidence: TAS. Frequency: Very frequent (HP:0040281). (ORPHA:1606)
- Long philtrum (HP:0000343): Distance between nasal base and midline upper lip vermilion border more than 2 SD above the mean. Alternatively, an apparently increased distance between nasal base and midline upper lip vermilion border. Evidence: TAS. Frequency: Very frequent (HP:0040281). (ORPHA:1606)
- Wide nasal bridge (HP:0000431): Increased breadth of the nasal bridge (and with it, the nasal root). Evidence: TAS. Frequency: Very frequent (HP:0040281). (ORPHA:1606)
- Deeply set eye (HP:0000490): An eye that is more deeply recessed into the plane of the face than is typical. Evidence: TAS. Frequency: Very frequent (HP:0040281). (ORPHA:1606)
- Delayed speech and language development (HP:0000750): A degree of language development that is significantly below the norm for a child of a specified age. Evidence: TAS. Frequency: Very frequent (HP:0040281). (ORPHA:1606)
- Brachydactyly (HP:0001156): Digits that appear disproportionately short compared to the hand/foot. The word brachydactyly is used here to describe a series distinct patterns of shortened digits (brachydactyly types A-E). This is the sense used here. Evidence: TAS. Frequency: Very frequent (HP:0040281). (ORPHA:1606)
- Intellectual disability (HP:0001249): The term intellectual disability or intellectual developmental disorder is used to describe significantly sub-average intellectual and adaptive functioning based on clinical assessment and as measured by individually administered, appropriately normed, standardized and validated tests of intellectual functioning and adaptive behavior, with onset during the developmental period from infancy through adolescence. Evidence: TAS. Frequency: Very frequent (HP:0040281). (ORPHA:1606)
- Hypotonia (HP:0001252): Hypotonia is an abnormally low muscle tone (the amount of tension or resistance to movement in a muscle). Even when relaxed, muscles have a continuous and passive partial contraction which provides some resistance to passive stretching. Hypotonia thus manifests as diminished resistance to passive stretching. Hypotonia is not the same as muscle weakness, although the two conditions can co-exist. Evidence: TAS. Frequency: Very frequent (HP:0040281). (ORPHA:1606)
- Global developmental delay (HP:0001263): A delay in the achievement of motor or mental milestones in the domains of development of a child, including motor skills, speech and language, cognitive skills, and social and emotional skills. This term should only be used to describe children younger than five years of age. Evidence: TAS. Frequency: Very frequent (HP:0040281). (ORPHA:1606)
- Agenesis of corpus callosum (HP:0001274): Absence of the corpus callosum as a result of the failure of the corpus callosum to develop, which can be the result of a failure in any one of the multiple steps of callosal development including cellular proliferation and migration, axonal growth or glial patterning at the midline. Evidence: TAS. Frequency: Very frequent (HP:0040281). (ORPHA:1606)
- Gait disturbance (HP:0001288): The term gait disturbance can refer to any disruption of the ability to walk. Evidence: TAS. Frequency: Very frequent (HP:0040281). (ORPHA:1606)
- Absent speech (HP:0001344): Complete lack of development of speech and language abilities. Evidence: TAS. Frequency: Very frequent (HP:0040281). (ORPHA:1606)
- Failure to thrive (HP:0001508): Failure to thrive (FTT) refers to a child whose physical growth is substantially below the norm. Evidence: TAS. Frequency: Very frequent (HP:0040281). (ORPHA:1606)
- Short foot (HP:0001773): A measured foot length that is more than 2 SD below the mean for a newborn of 27 - 41 weeks gestation, or foot that is less than the 3rd centile for individuals from birth to 16 years of age (objective). Alternatively, a foot that appears disproportionately short (subjective). Evidence: TAS. Frequency: Very frequent (HP:0040281). (ORPHA:1606)
- Ventriculomegaly (HP:0002119): An increase in size of the ventricular system of the brain. Evidence: TAS. Frequency: Very frequent (HP:0040281). (ORPHA:1606)
- Cerebral cortical atrophy (HP:0002120): Atrophy of the cortex of the cerebrum. Evidence: TAS. Frequency: Very frequent (HP:0040281). (ORPHA:1606)
- Abnormal speech pattern (HP:0002167): An abnormality in the sound (volume) or cadence (rate) of speech. Evidence: TAS. Frequency: Very frequent (HP:0040281). (ORPHA:1606)
- EEG abnormality (HP:0002353): Abnormality observed by electroencephalogram (EEG), which is used to record of the brain's spontaneous electrical activity from multiple electrodes placed on the scalp. Evidence: TAS. Frequency: Very frequent (HP:0040281). (ORPHA:1606)
- Poor speech (HP:0002465). Evidence: TAS. Frequency: Very frequent (HP:0040281). (ORPHA:1606)
- Horizontal eyebrow (HP:0011228): An eyebrow that extends straight across the brow, without curve. Evidence: TAS. Frequency: Very frequent (HP:0040281). (ORPHA:1606)
- Midface retrusion (HP:0011800): Posterior positions and/or vertical shortening of the infraorbital and perialar regions, or increased concavity of the face and/or reduced nasolabial angle. Evidence: TAS. Frequency: Very frequent (HP:0040281). (ORPHA:1606)
- Camptodactyly of finger (HP:0100490): The distal interphalangeal joint and/or the proximal interphalangeal joint of the fingers cannot be extended to 180 degrees by either active or passive extension. Evidence: TAS. Frequency: Very frequent (HP:0040281). (ORPHA:1606)
- Narrow mouth (HP:0000160): Distance between the commissures of the mouth more than 2 SD below the mean. Alternatively, an apparently decreased width of the oral aperture (subjective). Evidence: TAS. Frequency: Frequent (HP:0040282). (ORPHA:1606)
- Brachycephaly (HP:0000248): An abnormality of skull shape characterized by a decreased anterior-posterior diameter. That is, a cephalic index greater than 81%. Alternatively, an apparently shortened anteroposterior dimension (length) of the head compared to width. Evidence: TAS. Frequency: Frequent (HP:0040282). (ORPHA:1606)
- Microcephaly (HP:0000252): Head circumference below 2 standard deviations below the mean for age and gender. Evidence: TAS. Frequency: Frequent (HP:0040282). (ORPHA:1606)
- Delayed cranial suture closure (HP:0000270): Infants normally have two fontanels at birth, the diamond-shaped anterior fontanelle at the junction of the coronal and sagittal sutures, and the posterior fontanelle at the intersection of the occipital and parietal bones. The posterior fontanelle usually closes by the 8th week of life, and the anterior fontanel closes by the 18th month of life on average. This term applies if there is delay of closure of the fontanelles beyond the normal age. Evidence: TAS. Frequency: Frequent (HP:0040282). (ORPHA:1606)
- Epicanthus (HP:0000286): A fold of skin starting above the medial aspect of the upper eyelid and arching downward to cover, pass in front of and lateral to the medial canthus. Evidence: TAS. Frequency: Frequent (HP:0040282). (ORPHA:1606)
- Depressed nasal ridge (HP:0000457): Lack of prominence of the nose resulting from a posteriorly-placed nasal ridge. Evidence: TAS. Frequency: Frequent (HP:0040282). (ORPHA:1606)
- Strabismus (HP:0000486): A misalignment of the eyes so that the visual axes deviate from bifoveal fixation. The classification of strabismus may be based on a number of features including the relative position of the eyes, whether the deviation is latent or manifest, intermittent or constant, concomitant or otherwise and according to the age of onset and the relevance of any associated refractive error. Evidence: TAS. Frequency: Frequent (HP:0040282). (ORPHA:1606)
- Abnormality of vision (HP:0000504): Abnormality of eyesight (visual perception). Evidence: TAS. Frequency: Frequent (HP:0040282). (ORPHA:1606)
- Abnormal eyebrow morphology (HP:0000534): An abnormality of the eyebrow. Evidence: TAS. Frequency: Frequent (HP:0040282). (ORPHA:1606)
- Atypical behavior (HP:0000708): Atypical behavior is an abnormality in a person's actions that can be controlled or modulated by the will of the individual. While abnormal behaviors can be difficult to control, they are distinct from other abnormal actions that cannot be affected by the individual's will. Evidence: TAS. Frequency: Frequent (HP:0040282). (ORPHA:1606)
- Autism (HP:0000717): Autism is a neurodevelopmental disorder characterized by impaired social interaction and communication, and by restricted and repetitive behavior. Autism begins in childhood. It is marked by the presence of markedly abnormal or impaired development in social interaction and communication and a markedly restricted repertoire of activity and interest. Manifestations of the disorder vary greatly depending on the developmental level and chronological age of the individual (DSM-IV). Evidence: TAS. Frequency: Frequent (HP:0040282). (ORPHA:1606)
- Motor stereotypy (HP:0000733): Use of the same abnormal action in response to certain triggers or at random. They may be used as a way to regulate one's internal state but must otherwise have no apparent functional purpose. Evidence: TAS. Frequency: Frequent (HP:0040282). (ORPHA:1606)
- Seizure (HP:0001250): A seizure is an intermittent abnormality of nervous system physiology characterized by a transient occurrence of signs and/or symptoms due to abnormal excessive or synchronous neuronal activity in the brain. Evidence: TAS. Frequency: Frequent (HP:0040282). (ORPHA:1606)
- Dysphagia (HP:0002015): Difficulty in swallowing. Evidence: TAS. Frequency: Frequent (HP:0040282). (ORPHA:1606)
- Constipation (HP:0002019): Infrequent or difficult evacuation of feces. Evidence: TAS. Frequency: Frequent (HP:0040282). (ORPHA:1606)
- Gastroesophageal reflux (HP:0002020): A condition in which the stomach contents leak backwards from the stomach into the esophagus through the lower esophageal sphincter. Evidence: TAS. Frequency: Frequent (HP:0040282). (ORPHA:1606)
- Clinodactyly of the 5th finger (HP:0004209): Clinodactyly refers to a bending or curvature of the fifth finger in the radial direction (i.e., towards the 4th finger). Evidence: TAS. Frequency: Frequent (HP:0040282). (ORPHA:1606)
- Depressed nasal bridge (HP:0005280): Posterior positioning of the nasal root in relation to the overall facial profile for age. Evidence: TAS. Frequency: Frequent (HP:0040282). (ORPHA:1606)
- High hypermetropia (HP:0008499): A severe form of hypermetropia with over +5.00 diopters. Evidence: TAS. Frequency: Frequent (HP:0040282). (ORPHA:1606)
- Feeding difficulties in infancy (HP:0008872): Impaired feeding performance of an infant as manifested by difficulties such as weak and ineffective sucking, brief bursts of sucking, and falling asleep during sucking. There may be difficulties with chewing or maintaining attention. Evidence: TAS. Frequency: Frequent (HP:0040282). (ORPHA:1606)
- Abnormal cardiovascular system morphology (HP:0030680): Any structural anomaly of the heart and blood vessels. Evidence: TAS. Frequency: Frequent (HP:0040282). (ORPHA:1606)
- Self-injurious behavior (HP:0100716): Self-aggression. Evidence: TAS. Frequency: Frequent (HP:0040282). (ORPHA:1606)
- Cryptorchidism (HP:0000028): Testis in inguinal canal. That is, absence of one or both testes from the scrotum owing to failure of the testis or testes to descend through the inguinal canal to the scrotum. Evidence: TAS. Frequency: Occasional (HP:0040283). (ORPHA:1606)
- Hypospadias (HP:0000047): Abnormal position of urethral meatus on the ventral penile shaft (underside) characterized by displacement of the urethral meatus from the tip of the glans penis to the ventral surface of the penis, scrotum, or perineum. Evidence: TAS. Frequency: Occasional (HP:0040283). (ORPHA:1606)
- Abnormal female external genitalia morphology (HP:0000055): Any structural abnormality of the female external genitalia. Evidence: TAS. Frequency: Occasional (HP:0040283). (ORPHA:1606)
- Abnormality of the kidney (HP:0000077): An abnormality of the kidney. Evidence: TAS. Frequency: Occasional (HP:0040283). (ORPHA:1606)
- Renal cyst (HP:0000107): A fluid filled sac in the kidney. Evidence: TAS. Frequency: Occasional (HP:0040283). (ORPHA:1606)
- Hydronephrosis (HP:0000126): Severe distention of the kidney with dilation of the renal pelvis and calices. Evidence: TAS. Frequency: Occasional (HP:0040283). (ORPHA:1606)
- Hypogonadism (HP:0000135): A decreased functionality of the gonad. Evidence: TAS. Frequency: Occasional (HP:0040283). (ORPHA:1606)
- Conductive hearing impairment (HP:0000405): An abnormality of vibrational conductance of sound to the inner ear leading to impairment of sensory perception of sound. Evidence: TAS. Frequency: Occasional (HP:0040283). (ORPHA:1606)
- Sensorineural hearing impairment (HP:0000407): A type of hearing impairment in one or both ears related to an abnormal functionality of the cochlear nerve. Evidence: TAS. Frequency: Occasional (HP:0040283). (ORPHA:1606)
- Abnormality of the neck (HP:0000464): An abnormality of the neck. Evidence: TAS. Frequency: Occasional (HP:0040283). (ORPHA:1606)
- Visual impairment (HP:0000505): Visual impairment (or vision impairment) is vision loss (of a person) to such a degree as to qualify as an additional support need through a significant limitation of visual capability resulting from either disease, trauma, or congenital or degenerative conditions that cannot be corrected by conventional means, such as refractive correction, medication, or surgery. Evidence: TAS. Frequency: Occasional (HP:0040283). (ORPHA:1606)
- Cataract (HP:0000518): A cataract is an opacity or clouding that develops in the crystalline lens of the eye or in its capsule. Evidence: TAS. Frequency: Occasional (HP:0040283). (ORPHA:1606)
- Nystagmus (HP:0000639): Rhythmic, involuntary oscillations of one or both eyes related to abnormality in fixation, conjugate gaze, or vestibular mechanisms. Evidence: TAS. Frequency: Occasional (HP:0040283). (ORPHA:1606)
- Optic atrophy (HP:0000648): Atrophy of the optic nerve. Optic atrophy results from the death of the retinal ganglion cell axons that comprise the optic nerve and manifesting as a pale optic nerve on fundoscopy. Evidence: TAS. Frequency: Occasional (HP:0040283). (ORPHA:1606)
- Hypothyroidism (HP:0000821): Deficiency of thyroid hormone. Evidence: TAS. Frequency: Occasional (HP:0040283). (ORPHA:1606)
- 11 pairs of ribs (HP:0000878): Presence of only 11 pairs of ribs. Evidence: TAS. Frequency: Occasional (HP:0040283). (ORPHA:1606)
- Bifid ribs (HP:0000892): A bifid rib refers to cleavage of the sternal end of a rib, usually unilateral. Bifid ribs are usually asymptomatic, and are often discovered incidentally by chest x-ray. Evidence: TAS. Frequency: Occasional (HP:0040283). (ORPHA:1606)
- Rib fusion (HP:0000902): Complete or partial merging of adjacent ribs. Evidence: TAS. Frequency: Occasional (HP:0040283). (ORPHA:1606)
- Telangiectasia (HP:0001009): Telangiectasias refer to small dilated blood vessels located near the surface of the skin or mucous membranes, measuring between 0.5 and 1 millimeter in diameter. Telangiectasia are located especially on the tongue, lips, palate, fingers, face, conjunctiva, trunk, nail beds, and fingertips. Evidence: TAS. Frequency: Occasional (HP:0040283). (ORPHA:1606)
- Ocular albinism (HP:0001107): An abnormal reduction in the amount of pigmentation (reduced or absent) of the iris and retina. Evidence: TAS. Frequency: Occasional (HP:0040283). (ORPHA:1606)
- Hip dysplasia (HP:0001385): The presence of developmental dysplasia of the hip. Evidence: TAS. Frequency: Occasional (HP:0040283). (ORPHA:1606)
- Joint stiffness (HP:0001387): Joint stiffness is a perceived sensation of tightness in a joint or joints when attempting to move them after a period of inactivity. Joint stiffness typically subsides over time. Evidence: TAS. Frequency: Occasional (HP:0040283). (ORPHA:1606)
- Abnormality of the liver (HP:0001392): An abnormality of the liver. Evidence: TAS. Frequency: Occasional (HP:0040283). (ORPHA:1606)
- Hepatic steatosis (HP:0001397): Steatosis is a term used to denote lipid accumulation within hepatocytes. Evidence: TAS. Frequency: Occasional (HP:0040283). (ORPHA:1606)
- Obesity (HP:0001513): Accumulation of substantial excess body fat. Evidence: TAS. Frequency: Occasional (HP:0040283). (ORPHA:1606)
- Tetralogy of Fallot (HP:0001636): A congenital cardiac malformation comprising pulmonary stenosis, overriding aorta, ventricular septum defect, and right ventricular hypertrophy. The diagnosis of TOF is made if at least three of the four above mentioned features are present. Evidence: TAS. Frequency: Occasional (HP:0040283). (ORPHA:1606)
- Patent ductus arteriosus (HP:0001643): In utero, the ductus arteriosus (DA) serves to divert ventricular output away from the lungs and toward the placenta by connecting the main pulmonary artery to the descending aorta. A patent ductus arteriosus (PDA) in the first 3 days of life is a physiologic shunt in healthy term and preterm newborn infants, and normally is substantially closed within about 24 hours after bith and completely closed after about three weeks. Failure of physiologcal closure is referred to a persistent or patent ductus arteriosus (PDA). Depending on the degree of left-to-right shunting, PDA can have clinical consequences. Evidence: TAS. Frequency: Occasional (HP:0040283). (ORPHA:1606)
- Dilated cardiomyopathy (HP:0001644): Dilated cardiomyopathy (DCM) is defined by the presence of left ventricular dilatation and left ventricular systolic dysfunction in the absence of abnormal loading conditions (hypertension, valve disease) or coronary artery disease sufficient to cause global systolic impairment. Right ventricular dilation and dysfunction may be present but are not necessary for the diagnosis. Evidence: TAS. Frequency: Occasional (HP:0040283). (ORPHA:1606)
- Abnormal heart valve morphology (HP:0001654): Any structural abnormality of a cardiac valve. Evidence: TAS. Frequency: Occasional (HP:0040283). (ORPHA:1606)
- Abnormal cardiac septum morphology (HP:0001671): An anomaly of the intra-atrial or intraventricular septum. Evidence: TAS. Frequency: Occasional (HP:0040283). (ORPHA:1606)
- Annular pancreas (HP:0001734): A congenital anomaly in which the pancreas completely (or sometimes incompletely) encircles the second portion of duodenum and occasionally obstructs the more proximal duodenum. Evidence: TAS. Frequency: Occasional (HP:0040283). (ORPHA:1606)
- Abnormality of the spleen (HP:0001743): An abnormality of the spleen. Evidence: TAS. Frequency: Occasional (HP:0040283). (ORPHA:1606)
- Foot polydactyly (HP:0001829): A kind of polydactyly characterized by the presence of a supernumerary toe or toes. Evidence: TAS. Frequency: Occasional (HP:0040283). (ORPHA:1606)
- Frontal bossing (HP:0002007): Bilateral bulging of the lateral frontal bone prominences with relative sparing of the midline. Evidence: TAS. Frequency: Occasional (HP:0040283). (ORPHA:1606)
- Pyloric stenosis (HP:0002021): Pyloric stenosis, also known as infantile hypertrophic pyloric stenosis, is an uncommon condition in infants characterized by abnormal thickening of the pylorus muscles in the stomach leading to gastric outlet obstruction. Clinically infants are well at birth. Then, at 3 to 6 weeks of age, the infants present with projectile vomiting, potentially leading to dehydration and weight loss. Evidence: TAS. Frequency: Occasional (HP:0040283). (ORPHA:1606)
- Generalized hirsutism (HP:0002230): Abnormally increased hair growth over much of the entire body. Evidence: TAS. Frequency: Occasional (HP:0040283). (ORPHA:1606)
- Abnormal intestine morphology (HP:0002242): An abnormality of the intestine. The closely related term enteropathy is used to refer to any disease of the intestine. Evidence: TAS. Frequency: Occasional (HP:0040283). (ORPHA:1606)
- Polyphagia (HP:0002591): A neurological anomaly with gross overeating associated with an abnormally strong desire or need to eat. Evidence: TAS. Frequency: Occasional (HP:0040283). (ORPHA:1606)
- Scoliosis (HP:0002650): The presence of an abnormal lateral curvature of the spine. Evidence: TAS. Frequency: Occasional (HP:0040283). (ORPHA:1606)
- Abnormality of the immune system (HP:0002715): An abnormality of the immune system. Evidence: TAS. Frequency: Occasional (HP:0040283). (ORPHA:1606)
- Kyphosis (HP:0002808): Exaggerated anterior convexity of the thoracic vertebral column. Evidence: TAS. Frequency: Occasional (HP:0040283). (ORPHA:1606)
- Neuroblastoma (HP:0003006): Neuroblastoma is a solid tumor that originate in neural crest cells of the sympathetic nervous system. Most neuroblastomas originate in the abdomen, and most abdominal neuroblastomas originate in the adrenal gland. Neuroblastomas can also originate in the thorax, usually in the posterior mediastinum. Evidence: TAS. Frequency: Occasional (HP:0040283). (ORPHA:1606)
- Myopathy (HP:0003198): A disorder of muscle unrelated to impairment of innervation or neuromuscular junction. Evidence: TAS. Frequency: Occasional (HP:0040283). (ORPHA:1606)
- Spinal canal stenosis (HP:0003416): An abnormal narrowing of the spinal canal. Evidence: TAS. Frequency: Occasional (HP:0040283). (ORPHA:1606)
- Short stature (HP:0004322): A height below that which is expected according to age and gender norms. Although there is no universally accepted definition of short stature, many refer to "short stature" as height more than 2 standard deviations below the mean for age and gender (or below the 3rd percentile for age and gender dependent norms). Evidence: TAS. Frequency: Occasional (HP:0040283). (ORPHA:1606)
- Hemiplegia/hemiparesis (HP:0004374): Loss of strength in the arm, leg, and sometimes face on one side of the body. Hemiplegia refers to a severe or complete loss of strength, whereas hemiparesis refers to a relatively mild loss of strength. Evidence: TAS. Frequency: Occasional (HP:0040283). (ORPHA:1606)
- Abnormality of the anus (HP:0004378): Abnormality of the anal canal. Evidence: TAS. Frequency: Occasional (HP:0040283). (ORPHA:1606)
- Aortic arch aneurysm (HP:0005113): An abnormal localized widening (dilatation) of the aortic arch. Evidence: TAS. Frequency: Occasional (HP:0040283). (ORPHA:1606)
- Cranial nerve paralysis (HP:0006824). Evidence: TAS. Frequency: Occasional (HP:0040283). (ORPHA:1606)
- Abnormal blistering of the skin (HP:0008066): The presence of one or more bullae on the skin, defined as fluid-filled blisters more than 5 mm in diameter with thin walls. Evidence: TAS. Frequency: Occasional (HP:0040283). (ORPHA:1606)
- Microtia (HP:0008551): Underdevelopment of the external ear. Evidence: TAS. Frequency: Occasional (HP:0040283). (ORPHA:1606)
- Hypoplasia of penis (HP:0008736). Evidence: TAS. Frequency: Occasional (HP:0040283). (ORPHA:1606)
- Macule (HP:0012733): A flat, distinct, discolored area of skin less than 1 cm wide that does not involve any change in the thickness or texture of the skin. Evidence: TAS. Frequency: Occasional (HP:0040283). (ORPHA:1606)
- Lower limb asymmetry (HP:0100559): A difference in length or diameter between the left and right leg. Evidence: TAS. Frequency: Occasional (HP:0040283). (ORPHA:1606)
- Posteriorly rotated ears (HP:0000358): A type of abnormal location of the ears in which the position of the ears is characterized by posterior rotation (the superior part of the ears is rotated towards the back of the head, and the inferior part of the ears towards the front). Evidence: TAS. Frequency: Frequent (HP:0040282). (ORPHA:1606)
These phenotypes are associated with the disease 1p36 deletion syndrome (ORPHA:1606).